- Cleft palate (HP:0000175): Cleft palate is a developmental defect of the palate resulting from a failure of fusion of the palatine processes and manifesting as a separation of the roof of the mouth (soft and hard palate). Evidence: IEA. (OMIM:303400)
- Bifid uvula (HP:0000193): Uvula separated into two parts most easily seen at the tip. Evidence: IEA. (OMIM:303400)
- Ankyloglossia (HP:0010296): Short or anteriorly attached lingual frenulum, associated with limited mobility of the tongue. Evidence: IEA. (OMIM:303400)
- X-linked inheritance (HP:0001417): A mode of inheritance that is observed for traits related to a gene encoded on the X chromosome. Evidence: IEA. (OMIM:303400)
These phenotypes are associated with the disease cleft palate with or without ankyloglossia, X-linked (OMIM:303400).